Phenotypes associated with the disease spinocerebellar ataxia, autosomal recessive 22 (OMIM:616948):
- Truncal ataxia (HP:0002078): Truncal ataxia is a sign of ataxia characterized by instability of the trunk. It usually occurs during sitting. Evidence: PCS. (PMID:26157035)
- Hypoplasia of the corpus callosum (HP:0002079): Underdevelopment of the corpus callosum. Evidence: PCS. (PMID:26157035)
- Dysmetria (HP:0001310): A type of ataxia characterized by the inability to carry out movements with the correct range and motion across the plane of more than one joint related to incorrect estimation of the distances required for targeted movements. Evidence: PCS. (PMID:26157035)
- Cerebellar atrophy (HP:0001272): Cerebellar atrophy is defined as a cerebellum with initially normal structures, in a posterior fossa with normal size, which displays enlarged fissures (interfolial spaces) in comparison to the foliae secondary to loss of tissue. Cerebellar atrophy implies irreversible loss of tissue and result from an ongoing progressive disease until a final stage is reached or a single injury, e.g. an intoxication or infectious event. Evidence: PCS. (PMID:26157035)
- Dysarthria (HP:0001260): Dysarthric speech is a general description referring to a neurological speech disorder characterized by poor articulation. Depending on the involved neurological structures, dysarthria may be further classified as spastic, flaccid, ataxic, hyperkinetic and hypokinetic, or mixed. Evidence: PCS. (PMID:26157035)
- Ataxia (HP:0001251): Ataxia refers to impaired coordination of voluntary muscle movement. Cerebellar ataxia refers to ataxia due to dysfunction of the cerebellum. This causes a variety of elementary neurological deficits including asynergy (lack of coordination between muscles, limbs and joints), dysmetria (lack of ability to judge distances that can lead to under- or overshoot in grasping movements), and dysdiadochokinesia (inability to perform rapid movements requiring antagonizing muscle groups to be switched on and off repeatedly). Evidence: PCS. (PMID:26157035)
- Lower limb spasticity (HP:0002061): Spasticity (velocity-dependent increase in tonic stretch reflexes with increased muscle tone and hyperexcitable tendon reflexes) in the muscles of the lower limbs, hips, and pelvis. Evidence: PCS. (PMID:26157035)
- Intention tremor (HP:0002080): A type of kinetic tremor that occurs during target directed movement is called intention tremor. That is, an oscillatory cerebellar ataxia that tends to be absent when the limbs are inactive and during the first part of voluntary movement but worsening as the movement continues and greater precision is required (e.g., in touching a target such as the patient's nose or a physician's finger). Evidence: PCS. (PMID:26157035)
- Nystagmus (HP:0000639): Rhythmic, involuntary oscillations of one or both eyes related to abnormality in fixation, conjugate gaze, or vestibular mechanisms. Evidence: TAS. (OMIM:616948)
- Autosomal recessive inheritance (HP:0000007): A mode of inheritance that is observed for traits related to a gene encoded on one of the autosomes (i.e., the human chromosomes 1-22) in which a trait manifests in individuals with two pathogenic alleles, either homozygotes (two copies of the same mutant allele) or compound heterozygotes (whereby each copy of a gene has a distinct mutant allele). Evidence: PCS. (PMID:26157035)
- Abnormal pyramidal sign (HP:0007256): Functional neurological abnormalities related to dysfunction of the pyramidal tract. Evidence: PCS. (PMID:26157035)
- Unsteady gait (HP:0002317). Evidence: PCS. (PMID:26157035)
- Slowly progressive (HP:0003677): Applies to a disease manifestation that only slowly increases in scope or severity over the course of time. Evidence: TAS. (OMIM:616948)
- Intellectual disability (HP:0001249): The term intellectual disability or intellectual developmental disorder is used to describe significantly sub-average intellectual and adaptive functioning based on clinical assessment and as measured by individually administered, appropriately normed, standardized and validated tests of intellectual functioning and adaptive behavior, with onset during the developmental period from infancy through adolescence. Evidence: TAS. (OMIM:616948)
- Hyperreflexia (HP:0001347): Hyperreflexia is the presence of hyperactive stretch reflexes of the muscles. Evidence: PCS. (PMID:26157035)